- Congenital onset (HP:0003577): A phenotypic abnormality that is present at birth. Evidence: TAS. (OMIM:617021)
- Decreased liver function (HP:0001410): Reduced ability of the liver to perform its functions. Evidence: PCS. Frequency: 1/1. (PMID:26537577)
- Antenatal onset (HP:0030674): Onset prior to birth. Evidence: PCS. Frequency: 1/1. (PMID:26537577)
- Seizure (HP:0001250): A seizure is an intermittent abnormality of nervous system physiology characterized by a transient occurrence of signs and/or symptoms due to abnormal excessive or synchronous neuronal activity in the brain. Evidence: PCS. Frequency: 1/1. (PMID:26537577)
- Nonimmune hydrops fetalis (HP:0001790): A type of hydrops fetalis in which there is no identifiable circulating antibody to red blood cell antigens . Evidence: PCS. Frequency: 1/1. (PMID:26537577)
- Hypoalbuminemia (HP:0003073): The concentration of albumin in the blood circulation is below the lower limit of normal. Evidence: PCS. Frequency: 1/1. (PMID:26537577)
- Erythroid hyperplasia (HP:0012132): Increased count of erythroid precursor cells, that is, erythroid lineage cells in the bone marrow. Evidence: PCS. Frequency: 1/1. (PMID:26537577)
- Ventricular septal defect (HP:0001629): A hole between the two bottom chambers (ventricles) of the heart. The defect is centered around the most superior aspect of the ventricular septum. Evidence: PCS. Frequency: 1/1. (PMID:26537577)
- Anemia (HP:0001903): A reduction in erythrocytes volume or hemoglobin concentration. Evidence: PCS. Frequency: 1/1. (PMID:26537577)
- Sideroblastic anemia (HP:0001924): Sideroblastic anemia results from a defect in the incorporation of iron into the heme molecule. A sideroblast is an erythroblast that has stainable deposits of iron in cytoplasm (this can be demonstrated by Prussian blue staining). Evidence: TAS. (OMIM:617021)
- Patent ductus arteriosus (HP:0001643): In utero, the ductus arteriosus (DA) serves to divert ventricular output away from the lungs and toward the placenta by connecting the main pulmonary artery to the descending aorta. A patent ductus arteriosus (PDA) in the first 3 days of life is a physiologic shunt in healthy term and preterm newborn infants, and normally is substantially closed within about 24 hours after bith and completely closed after about three weeks. Failure of physiologcal closure is referred to a persistent or patent ductus arteriosus (PDA). Depending on the degree of left-to-right shunting, PDA can have clinical consequences. Evidence: PCS. Frequency: 1/1. (PMID:26537577)
- Metabolic acidosis (HP:0001942): Metabolic acidosis (MA) is characterized by a fall in blood pH due to a reduction of serum bicarbonate concentration. This can occur as a result of either the accumulation of acids (high anion gap MA) or the loss of bicarbonate from the gastrointestinal tract or the kidney (hyperchloremic MA). By definition, MA is not due to a respirary cause. Evidence: PCS. Frequency: 1/1. (PMID:26537577)
- Lactic acidosis (HP:0003128): An abnormal buildup of lactic acid in the body, leading to acidification of the blood and other bodily fluids. Evidence: PCS. Frequency: 1/1. (PMID:26537577)
- Oligohydramnios (HP:0001562): Diminished amniotic fluid volume in pregnancy. Evidence: PCS. Frequency: 1/1. (PMID:26537577)
- Fetal pericardial effusion (HP:0025671): An abnormal accumulation of fluid in which the heart is partially or completely surrounded by fluid that is seen in all views and the thickness of the fluid as observed by prenatal ultrasound is above age-dependent norms. Evidence: PCS. Frequency: 1/1. (PMID:26537577)
- EEG abnormality (HP:0002353): Abnormality observed by electroencephalogram (EEG), which is used to record of the brain's spontaneous electrical activity from multiple electrodes placed on the scalp. Evidence: TAS. (OMIM:617021)
- Ascites (HP:0001541): Accumulation of fluid in the peritoneal cavity (between the layers of the peritoneum that lines the abdomen). Evidence: PCS. Frequency: 1/1. (PMID:26537577)
- Hematuria (HP:0000790): The presence of blood in the urine. Hematuria may be gross hematuria (visible to the naked eye) or microscopic hematuria (detected by dipstick or microscopic examination of the urine). Evidence: PCS. Frequency: 1/1. (PMID:26537577)
- Increased circulating lactate concentration (HP:0002151): Abnormally increased level of blood lactate (2-hydroxypropanoic acid). Lactate is produced from pyruvate by lactate dehydrogenase during normal metabolism. The terms lactate and lactic acid are often used interchangeably but lactate (the component measured in blood) is strictly a weak base whereas lactic acid is the corresponding acid. Lactic acidosis is often used clinically to describe elevated lactate but should be reserved for cases where there is a corresponding acidosis (pH below 7.35). Evidence: PCS. Frequency: 1/1. (PMID:26537577)
- Second degree atrioventricular block (HP:0011706): An intermittent atrioventricular block with failure of some atrial impulses to conduct to the ventricles, i.e., some but not all atrial impulses are conducted through the atrioventricular node and trigger ventricular contraction. Evidence: PCS. Frequency: 1/1. (PMID:26537577)
- Pulmonary arterial hypertension (HP:0002092): Pulmonary hypertension is defined mean pulmonary artery pressure of 25mmHg or more and pulmonary capillary wedge pressure of 15mmHg or less when measured by right heart catheterisation at rest and in a supine position. Evidence: PCS. Frequency: 1/1. (PMID:26537577)
- Respiratory insufficiency (HP:0002093). Evidence: TAS. (OMIM:617021)
- Small for gestational age (HP:0001518): Smaller than normal size according to sex and gestational age related norms, defined as a weight below the 10th percentile for the gestational age. Evidence: PCS. Frequency: 1/1. (PMID:26537577)
- Hypertension (HP:0000822): The presence of chronic increased pressure in the systemic arterial system. Evidence: IEA. (OMIM:617021)
- Autosomal recessive inheritance (HP:0000007): A mode of inheritance that is observed for traits related to a gene encoded on one of the autosomes (i.e., the human chromosomes 1-22) in which a trait manifests in individuals with two pathogenic alleles, either homozygotes (two copies of the same mutant allele) or compound heterozygotes (whereby each copy of a gene has a distinct mutant allele). Evidence: PCS. (PMID:26537577)
- Extramedullary hematopoiesis (HP:0001978): The process of hematopoiesis occurring outside of the bone marrow (in the liver, thymus, and spleen) in the postnatal organisms. Evidence: PCS. Frequency: 1/1. (PMID:26537577)
- Increased mean corpuscular volume (HP:0005518): Larger than normal size of erythrocytes. Evidence: PCS. Frequency: 1/1. (PMID:26537577)
- Intrauterine growth retardation (HP:0001511): An abnormal restriction of fetal growth with fetal weight below the tenth percentile for gestational age. Evidence: PCS. Frequency: 1/1. (PMID:26537577)
- Overriding aorta (HP:0002623): An overriding aorta is a congenital heart defect where the aorta is positioned directly over a ventricular septal defect, instead of over the left ventricle. The result is that the aorta receives some blood from the right ventricle, which reduces the amount of oxygen in the blood. It is one of the four conditions of the Tetralogy of Fallot. The aortic root can be displaced toward the front (anteriorly) or directly above the septal defect, but it is always abnormally located to the right of the root of the pulmonary artery. The degree of override is quite variable, with 5-95% of the valve being connected to the right ventricle. Evidence: PCS. Frequency: 1/1. (PMID:26537577)
- Thrombocytopenia (HP:0001873): A reduction in the number of circulating thrombocytes. Evidence: TAS. (OMIM:617021)
These phenotypes are associated with the disease hydrops-lactic acidosis-sideroblastic anemia-multisystemic failure syndrome (OMIM:617021).